- Erythroid hypoplasia (HP:0012133): Decreased count of erythroid precursor cells, that is, erythroid lineage cells in the bone marrow. Evidence: PCS. Frequency: 2/2. (PMID:28280134)
- Steroid-responsive anemia (HP:0033074): Amelioration of anemia upon treatment with a steroid medication. Evidence: PCS. Frequency: 1/2. Onset: Infantile onset (HP:0003593). (PMID:28280134)
- Anemia (HP:0001903): A reduction in erythrocytes volume or hemoglobin concentration. Evidence: PCS. Frequency: 2/2. Onset: Infantile onset (HP:0003593). (PMID:28280134)
- Autosomal dominant inheritance (HP:0000006): A mode of inheritance that is observed for traits related to a gene encoded on one of the autosomes (i.e., the human chromosomes 1-22) in which a trait manifests in heterozygotes. In the context of medical genetics, an autosomal dominant disorder is caused when a single copy of the mutant allele is present. Males and females are affected equally, and can both transmit the disorder with a risk of 50% for each child of inheriting the mutant allele. Evidence: PCS. (PMID:28280134)
These phenotypes are associated with the disease Diamond-Blackfan anemia 19 (OMIM:618312).